Phenotypes associated with the disease Carney complex - trismus - pseudocamptodactyly syndrome (OMIM:608837):
- Trismus (HP:0000211): Limitation in the ability to open the mouth. Evidence: PCS. (PMID:15282353)
- Distal arthrogryposis (HP:0005684): An inherited primary limb malformation disorder characterized by congenital contractures of two or more different body areas and without primary neurologic and/or muscle disease that affects limb function. Evidence: PCS. (PMID:15282353)
- Cardiac myxoma (HP:0011672): A myxoma (tumor of primitive connective tissue) of the heart. Cardiac myxomas consist of stellate to plump, cytologically bland mesenchymal cells set in a myxoid stroma. Cardiac myxomas are of endocardial origin and general project from the endocardium into a cardiac chamber. Evidence: PCS. (PMID:15282353)
- Autosomal dominant inheritance (HP:0000006): A mode of inheritance that is observed for traits related to a gene encoded on one of the autosomes (i.e., the human chromosomes 1-22) in which a trait manifests in heterozygotes. In the context of medical genetics, an autosomal dominant disorder is caused when a single copy of the mutant allele is present. Males and females are affected equally, and can both transmit the disorder with a risk of 50% for each child of inheriting the mutant allele. Evidence: PCS. (PMID:15282353)